Phenotypes associated with the disease Pili bifurcati (ORPHA:720):
- Abnormal hair morphology (HP:0001595): An abnormality of the hair. Evidence: TAS. Frequency: Very frequent (HP:0040281). (ORPHA:720)
- Abnormality of hair texture (HP:0010719): An abnormality of the texture of the hair. Evidence: TAS. Frequency: Very frequent (HP:0040281). (ORPHA:720)